- Abnormal vestibular function (HP:0001751): An abnormality of the functioning of the vestibular apparatus. Evidence: TAS. Frequency: Occasional (HP:0040283). (ORPHA:231183)
- Abnormal cochlea morphology (HP:0000375): An abnormality of the cochlea. Evidence: TAS. Frequency: Very frequent (HP:0040281). (ORPHA:231183)
- Sensorineural hearing impairment (HP:0000407): A type of hearing impairment in one or both ears related to an abnormal functionality of the cochlear nerve. Evidence: TAS. Frequency: Very frequent (HP:0040281). (ORPHA:231183)
- Rod-cone dystrophy (HP:0000510): An inherited retinal disease subtype in which the rod photoreceptors appear to be more severely affected than the cone photoreceptors. Typical presentation is with nyctalopia (due to rod dysfunction) followed by loss of mid-peripheral field of vision, which gradually extends and leaves many patients with a small central island of vision due to the preservation of macular cones. Evidence: TAS. Frequency: Very frequent (HP:0040281). (ORPHA:231183)
- Abnormal electroretinogram (HP:0000512): Any abnormality of the electrical responses of various cell types in the retina as measured by electroretinography. Evidence: TAS. Frequency: Very frequent (HP:0040281). (ORPHA:231183)
- Visual loss (HP:0000572): Loss of visual acuity (implying that vision was better at a certain time point in life). Otherwise the term reduced visual acuity should be used (or a subclass of that). Evidence: TAS. Frequency: Very frequent (HP:0040281). (ORPHA:231183)
- Scotoma (HP:0000575): A regional and pathological increase of the light detection threshold in any region of the visual field surrounded by a field of normal or relatively well-preserved vision. Evidence: TAS. Frequency: Very frequent (HP:0040281). (ORPHA:231183)
- Nyctalopia (HP:0000662): Inability to see well at night or in poor light. Evidence: TAS. Frequency: Very frequent (HP:0040281). (ORPHA:231183)
- Vestibular hyporeflexia (HP:0001756): A general descriptive term that describes impaired functioning of the vestibular apparatus that leads to manifestations such as dizziness or postural imbalance. Evidence: TAS. Frequency: Very frequent (HP:0040281). (ORPHA:231183)
- Iris hypopigmentation (HP:0007730): An abnormal reduction in the amount of pigmentation of the iris. Evidence: TAS. Frequency: Very frequent (HP:0040281). (ORPHA:231183)
- Depression (HP:0000716): Frequently experiencing feelings of being down, miserable, and/or hopeless; struggling to recover from these moods; having a pessimistic outlook on the future; feeling a pervasive sense of shame; having a low self-worth; experiencing thoughts of suicide and engaging in suicidal behavior. Evidence: TAS. Frequency: Occasional (HP:0040283). (ORPHA:231183)
- Anxiety (HP:0000739): Intense feelings of nervousness, tension, or panic often arise in response to interpersonal stresses. There is worry about the negative effects of past unpleasant experiences and future negative possibilities. Individuals may feel fearful, apprehensive, or threatened by uncertainty, and they may also have fears of falling apart or losing control. Evidence: TAS. Frequency: Occasional (HP:0040283). (ORPHA:231183)
These phenotypes are associated with the disease Usher syndrome type 3 (ORPHA:231183).